Phenotypes associated with the disease Neuroendocrine tumor of the colon (ORPHA:100080):
- Bronchoconstriction (HP:4000007): Tightening of smooth muscle surrounding the bronchi and bronchioles with consequent wheezing and shortness of breath. Evidence: TAS. Frequency: Occasional (HP:0040283). (ORPHA:100080)
- Carcinoid tumor (HP:0100570): A tumor formed from the endocrine (argentaffin) cells of the mucosal lining of a variety of organs including the stomach and intestine. These cells are from neuroectodermal origin. Evidence: TAS. Frequency: Obligate (HP:0040280). (ORPHA:100080)
- Weight loss (HP:0001824): Reduction of total body weight. Evidence: TAS. Frequency: Frequent (HP:0040282). (ORPHA:100080)
- Abdominal pain (HP:0002027): An unpleasant sensation characterized by physical discomfort (such as pricking, throbbing, or aching) and perceived to originate in the abdomen. Evidence: TAS. Frequency: Frequent (HP:0040282). (ORPHA:100080)
- Anorexia (HP:0002039): Lack of desire to eat (loss of appetite). Evidence: TAS. Frequency: Frequent (HP:0040282). (ORPHA:100080)
- Hepatomegaly (HP:0002240): Abnormally increased size of the liver. Evidence: TAS. Frequency: Frequent (HP:0040282). (ORPHA:100080)
- Chronic noninfectious lymphadenopathy (HP:0002730): A chronic form of lymphadenopathy that is not related to infection. Evidence: TAS. Frequency: Frequent (HP:0040282). (ORPHA:100080)
- Bloody diarrhea (HP:0025085): Passage of many stools containing blood. Evidence: TAS. Frequency: Frequent (HP:0040282). (ORPHA:100080)
- Hypoactive bowel sounds (HP:0030144): An decreased amount of bowel sounds. Evidence: TAS. Frequency: Frequent (HP:0040282). (ORPHA:100080)
- Atypical pulmonary carcinoid tumor (HP:0030446). Evidence: TAS. Frequency: Frequent (HP:0040282). (ORPHA:100080)
- Right ventricular failure (HP:0001708): Reduced ability of the right ventricle to perform its function (to receive blood from the right atrium and to eject blood into the pulmonary artery), often leading to pitting peripheral edema, ascites, and hepatomegaly. Evidence: TAS. Frequency: Occasional (HP:0040283). (ORPHA:100080)
- Palpitations (HP:0001962): A sensation that the heart is pounding or racing, which is a non-specific sign but may be a manifestation of arrhythmia. Evidence: TAS. Frequency: Occasional (HP:0040283). (ORPHA:100080)
- Melena (HP:0002249): The passage of blackish, tarry feces associated with gastrointestinal hemorrhage. Melena occurs if the blood remains in the colon long enough for it to be broken down by colonic bacteria. One degradation product, hematin, imbues the stool with a blackish color. Thus, melena generally occurs with bleeding from the upper gastrointestinal tract (e.g., stomach ulcers or duodenal ulcers), since the blood usually remains in the gut for a longer period of time than with lower gastrointestinal bleeding. Evidence: TAS. Frequency: Occasional (HP:0040283). (ORPHA:100080)
- Hypotension (HP:0002615): Low Blood Pressure, vascular hypotension. Evidence: TAS. Frequency: Occasional (HP:0040283). (ORPHA:100080)
- Elevated circulating hepatic transaminase concentration (HP:0002910): Elevations of the levels of SGOT and SGPT in the serum. SGOT (serum glutamic oxaloacetic transaminase) and SGPT (serum glutamic pyruvic transaminase) are transaminases primarily found in the liver and heart and are released into the bloodstream as the result of liver or heart damage. SGOT and SGPT are used clinically mainly as markers of liver damage. Evidence: TAS. Frequency: Occasional (HP:0040283). (ORPHA:100080)
- Increased serum serotonin (HP:0003144): A increased concentration of serotonin in the blood. Evidence: TAS. Frequency: Occasional (HP:0040283). (ORPHA:100080)
- Protracted diarrhea (HP:0004385). Evidence: TAS. Frequency: Occasional (HP:0040283). (ORPHA:100080)
- Tricuspid regurgitation (HP:0005180): Failure of the tricuspid valve to close sufficiently upon contraction of the right ventricle, causing blood to regurgitate (flow backward) into the right atrium. Evidence: TAS. Frequency: Occasional (HP:0040283). (ORPHA:100080)
- Facial telangiectasia (HP:0007380): Telangiectases (small dilated blood vessels) located near the surface of the skin of the face. Evidence: TAS. Frequency: Occasional (HP:0040283). (ORPHA:100080)
- Bowel urgency (HP:0012701): A sudden, irresistible need to have a bowel movement. Evidence: TAS. Frequency: Occasional (HP:0040283). (ORPHA:100080)
- Lack of bowel sounds (HP:0030145): Complete lack of abdominal sounds as assayed by examination of the abdomen with a stethoscope. Evidence: TAS. Frequency: Occasional (HP:0040283). (ORPHA:100080)
- Abnormal pulmonary valve cusp morphology (HP:0031566): Any structural anomaly of the pulmonary valve leaflets. Evidence: TAS. Frequency: Occasional (HP:0040283). (ORPHA:100080)